Phenotypes associated with the disease Duane retraction syndrome 2 (OMIM:604356):
- Strabismus (HP:0000486): A misalignment of the eyes so that the visual axes deviate from bifoveal fixation. The classification of strabismus may be based on a number of features including the relative position of the eyes, whether the deviation is latent or manifest, intermittent or constant, concomitant or otherwise and according to the age of onset and the relevance of any associated refractive error. Evidence: PCS. (PMID:18653847)
- Amblyopia (HP:0000646): Reduced visual acuity that is uncorrectable by lenses in the absence of detectable anatomic defects in the eye or visual pathways. Evidence: PCS. (PMID:18653847)
- Duane anomaly (HP:0009921): A condition associated with a limitation of the horizontal ocular movement with retraction of the globe and narrowing of the palpebral fissure on adduction. Evidence: PCS. (PMID:18653847)
- Autosomal dominant inheritance (HP:0000006): A mode of inheritance that is observed for traits related to a gene encoded on one of the autosomes (i.e., the human chromosomes 1-22) in which a trait manifests in heterozygotes. In the context of medical genetics, an autosomal dominant disorder is caused when a single copy of the mutant allele is present. Males and females are affected equally, and can both transmit the disorder with a risk of 50% for each child of inheriting the mutant allele. Evidence: PCS. (PMID:18653847)